Phenotypes associated with the disease Adamantinoma (ORPHA:55881):
- Bone pain (HP:0002653): An unpleasant sensation characterized by physical discomfort (such as pricking, throbbing, or aching) localized to bone. Evidence: TAS. Frequency: Frequent (HP:0040282). (ORPHA:55881)
- Pathologic fracture (HP:0002756): A pathologic fracture occurs when a bone breaks in an area that is weakened secondarily to another disease process such as tumor, infection, and certain inherited bone disorders. A pathologic fracture can occur without a degree of trauma required to cause fracture in healthy bone. Evidence: TAS. Frequency: Occasional (HP:0040283). (ORPHA:55881)
- Hypercalcemia (HP:0003072): The concentration of calcium in the blood circulation is above the upper limit of normal. Evidence: TAS. Frequency: Occasional (HP:0040283). (ORPHA:55881)